Phenotypes associated with the disease Familial keratoacanthoma (ORPHA:493):
- Hyperkeratosis (HP:0000962): Hyperkeratosis is a histopathological term defining a thickened stratum corneum and may be present in many different skin conditions, with many possible overlaps. Hyperkeratosis refers to the increased thickness of the stratum corneum, the outer layer of the skin. Hyperkeratosis is subclassified as orthokeratotic or parakeratotic. Orthokeratotic hyperkeratosis refers to the thickening of the keratin layer with preserved keratinocyte maturation, while parakeratotic hyperkeratosis shows retained nuclei as a sign of delayed maturation of keratinocytes. Evidence: TAS. Frequency: Very frequent (HP:0040281). (ORPHA:493)
- Subcutaneous nodule (HP:0001482): Slightly elevated lesions on or in the skin with a diameter of over 5 mm. Evidence: TAS. Frequency: Very frequent (HP:0040281). (ORPHA:493)
- Neoplasm (HP:0002664): An organ or organ-system abnormality that consists of uncontrolled autonomous cell-proliferation which can occur in any part of the body as a benign or malignant neoplasm (tumor). Evidence: TAS. Frequency: Occasional (HP:0040283). (ORPHA:493)
- Adenoma sebaceum (HP:0009720): The presence of a sebaceous adenoma with origin in the sebum secreting cells of the skin. Evidence: TAS. Frequency: Very frequent (HP:0040281). (ORPHA:493)
- Papilloma (HP:0012740): A tumor of the skin or mucous membrane with finger-like projections. Evidence: TAS. Frequency: Frequent (HP:0040282). (ORPHA:493)
- Papule (HP:0200034): A circumscribed, solid elevation of skin with no visible fluid, varying in size from a pinhead to less than 10mm in diameter at the widest point. Evidence: TAS. Frequency: Very frequent (HP:0040281). (ORPHA:493)
- Skin ulcer (HP:0200042): A discontinuity of the skin exhibiting complete loss of the epidermis and often portions of the dermis and even subcutaneous fat. Evidence: TAS. Frequency: Very frequent (HP:0040281). (ORPHA:493)